Phenotypes associated with the disease polydactyly, postaxial, type a7 (OMIM:617642):
- Congenital onset (HP:0003577): A phenotypic abnormality that is present at birth. Evidence: PCS. Frequency: 4/4. (PMID:28488682)
- Postaxial hand polydactyly (HP:0001162): Supernumerary digits located at the ulnar side of the hand (that is, on the side with the fifth finger). Evidence: PCS. Frequency: 0/4. (PMID:28488682)
- 2-3 toe cutaneous syndactyly (HP:0005709). Evidence: PCS. Frequency: 1/4. (PMID:28488682)
- Autosomal recessive inheritance (HP:0000007): A mode of inheritance that is observed for traits related to a gene encoded on one of the autosomes (i.e., the human chromosomes 1-22) in which a trait manifests in individuals with two pathogenic alleles, either homozygotes (two copies of the same mutant allele) or compound heterozygotes (whereby each copy of a gene has a distinct mutant allele). Evidence: PCS. (PMID:28488682)
- Short fifth metatarsal (HP:0004704): Short (hypoplastic) fifth metatarsal bone. Evidence: PCS. Frequency: 1/4. (PMID:28488682)
- Postaxial foot polydactyly (HP:0001830): Polydactyly of the foot most commonly refers to the presence of six toes on one foot. Postaxial polydactyly affects the lateral ray and the duplication may range from a well-formed articulated digit to a rudimentary digit. Evidence: PCS. Frequency: 4/4. (PMID:28488682)